- Hypertonia (HP:0001276): A condition in which there is increased muscle tone so that arms or legs, for example, are stiff and difficult to move. Evidence: TAS. Frequency: Very frequent (HP:0040281). (ORPHA:256)
- Gait disturbance (HP:0001288): The term gait disturbance can refer to any disruption of the ability to walk. Evidence: TAS. Frequency: Very frequent (HP:0040281). (ORPHA:256)
- Abnormality of the voice (HP:0001608). Evidence: TAS. Frequency: Frequent (HP:0040282). (ORPHA:256)
- Abnormality of the musculature (HP:0003011): Abnormality originating in one or more muscles, i.e., of the set of muscles of body. Evidence: TAS. Frequency: Very frequent (HP:0040281). (ORPHA:256)
- Abnormality of movement (HP:0100022): An abnormality of movement with a neurological basis characterized by changes in coordination and speed of voluntary movements. Evidence: TAS. Frequency: Very frequent (HP:0040281). (ORPHA:256)
These phenotypes are associated with the disease Early-onset generalized limb-onset dystonia (ORPHA:256).